- Extracranial internal carotid artery dissection (HP:0004945, a Human Phenotype Ontology term): A separation (dissection) of the layers of the extracranial portion of the internal carotid artery wall. Evidence: IEA. (OMIM:147820)
- Autosomal dominant inheritance (HP:0000006, a Human Phenotype Ontology term): A mode of inheritance that is observed for traits related to a gene encoded on one of the autosomes (i.e., the human chromosomes 1-22) in which a trait manifests in heterozygotes. In the context of medical genetics, an autosomal dominant disorder is caused when a single copy of the mutant allele is present. Males and females are affected equally, and can both transmit the disorder with a risk of 50% for each child of inheriting the mutant allele. Evidence: IEA. (OMIM:147820)
These phenotypes are associated with the disease internal carotid artery, spontaneous dissection of (OMIM:147820, an entry in Online Mendelian Inheritance in Man).